Phenotypes associated with the disease mitral valve prolapse, myxomatous 3 (OMIM:610840):
- Mitral regurgitation (HP:0001653): An abnormality of the mitral valve characterized by insufficiency or incompetence of the mitral valve resulting in retrograde leaking of blood through the mitral valve upon ventricular contraction. Evidence: PCS. (PMID:31118289)
- Autosomal dominant inheritance (HP:0000006): A mode of inheritance that is observed for traits related to a gene encoded on one of the autosomes (i.e., the human chromosomes 1-22) in which a trait manifests in heterozygotes. In the context of medical genetics, an autosomal dominant disorder is caused when a single copy of the mutant allele is present. Males and females are affected equally, and can both transmit the disorder with a risk of 50% for each child of inheriting the mutant allele. Evidence: PCS. (PMID:31118289)
- Mitral valve prolapse (HP:0001634): One or both of the leaflets (cusps) of the mitral valve bulges back into the left atrium upon contraction of the left ventricle. Evidence: PCS. (PMID:31118289)
- Typified by age-related disease onset (HP:0003831): Description of conditions in which age of onset is typically later in life and in which penetrance is dependent on the age of the subject. Evidence: PCS. (PMID:31118289)